- Narrow forehead (HP:0000341): Width of the forehead or distance between the frontotemporales is more than two standard deviations below the mean (objective); or apparently narrow intertemporal region (subjective). Evidence: PCS. Frequency: 1/2. (PMID:25748484)
- Long philtrum (HP:0000343): Distance between nasal base and midline upper lip vermilion border more than 2 SD above the mean. Alternatively, an apparently increased distance between nasal base and midline upper lip vermilion border. Evidence: PCS. Frequency: 1/2. (PMID:25748484)
- Short stature (HP:0004322): A height below that which is expected according to age and gender norms. Although there is no universally accepted definition of short stature, many refer to "short stature" as height more than 2 standard deviations below the mean for age and gender (or below the 3rd percentile for age and gender dependent norms). Evidence: PCS. Frequency: 1/2. (PMID:25748484)
- Myopathy (HP:0003198): A disorder of muscle unrelated to impairment of innervation or neuromuscular junction. Evidence: PCS. (PMID:25748484)
- Flexion contracture (HP:0001371): A flexion contracture is a bent (flexed) joint that cannot be straightened actively or passively. It is thus a chronic loss of joint motion due to structural changes in muscle, tendons, ligaments, or skin that prevents normal movement of joints. Evidence: IEA. (OMIM:616549)
- Acetabular dysplasia (HP:0008807): A smaller than normal acetabulum that has insufficient femoral head coverage leading to abnormal hip joint contact pressures, instability and pain. Evidence: TAS. (OMIM:616549)
- Low posterior hairline (HP:0002162): Hair on the neck extends more inferiorly than usual. Evidence: PCS. Frequency: 2/2. (PMID:25748484)
- Generalized hypotonia (HP:0001290): Generalized muscular hypotonia (abnormally low muscle tone). Evidence: PCS. Frequency: 1/2. (PMID:25748484)
- Motor delay (HP:0001270): A type of Developmental delay characterized by a delay in acquiring motor skills. Evidence: PCS. Frequency: 1/2. (PMID:25748484)
- Bulbous nose (HP:0000414): Increased volume and globular shape of the anteroinferior aspect of the nose. Evidence: PCS. Frequency: 2/2. (PMID:25748484)
- Thin upper lip vermilion (HP:0000219): Height of the vermilion of the upper lip in the midline more than 2 SD below the mean. Alternatively, an apparently reduced height of the vermilion of the upper lip in the frontal view (subjective). Evidence: PCS. Frequency: 1/2. (PMID:25748484)
- High palate (HP:0000218): Height of the palate more than 2 SD above the mean (objective) or palatal height at the level of the first permanent molar more than twice the height of the teeth (subjective). Evidence: PCS. Frequency: 1/2. (PMID:25748484)
- Microcephaly (HP:0000252): Head circumference below 2 standard deviations below the mean for age and gender. Evidence: PCS. Frequency: 2/2. (PMID:25748484)
- Underdeveloped nasal alae (HP:0000430): Thinned, deficient, or excessively arched ala nasi. Evidence: PCS. Frequency: 1/2. (PMID:25748484)
- Everted lower lip vermilion (HP:0000232): An abnormal configuration of the lower lip such that it is turned outward i.e., everted, with the Inner aspect of the lower lip vermilion (normally opposing the teeth) being visible in a frontal view. Evidence: PCS. Frequency: 1/2. (PMID:25748484)
- Short neck (HP:0000470): Diminished length of the neck. Evidence: TAS. (OMIM:616549)
- Ptosis (HP:0000508): The upper eyelid margin is positioned 3 mm or more lower than usual and covers the superior portion of the iris (objective); or, the upper lid margin obscures at least part of the pupil (subjective). Evidence: PCS. Frequency: 2/2. (PMID:25748484)
- Autosomal recessive inheritance (HP:0000007): A mode of inheritance that is observed for traits related to a gene encoded on one of the autosomes (i.e., the human chromosomes 1-22) in which a trait manifests in individuals with two pathogenic alleles, either homozygotes (two copies of the same mutant allele) or compound heterozygotes (whereby each copy of a gene has a distinct mutant allele). Evidence: PCS. (PMID:25748484)
- Thoracolumbar scoliosis (HP:0002944). Evidence: TAS. (OMIM:616549)
- Cardiomyopathy (HP:0001638): A myocardial disorder in which the heart muscle is structurally and functionally abnormal, in the absence of coronary artery disease, hypertension, valvular disease and congenital heart disease sufficient to cause the observed myocardial abnormality. Evidence: IEA. (OMIM:616549)
- Webbed neck (HP:0000465): Pterygium colli is a congenital skin fold that runs along the sides of the neck down to the shoulders. It involves an ectopic fibrotic facial band superficial to the trapezius muscle. Excess hair-bearing skin is also present and extends down the cervical region well beyond the normal hairline. Evidence: PCS. Frequency: 2/2. Onset: Congenital onset (HP:0003577). (PMID:25748484)
- Nemaline bodies (HP:0003798): Nemaline rods are abnormal bodies that can occur in skeletal muscle fibers. The rods can be observed on histological analysis of muscle biopsy tissue or upon electron microscopy, where they appear either as extensions of sarcomeric Z-lines, in random array without obvious attachment to Z-lines (often in areas devoid of sarcomeres) or in large clusters localized at the sarcolemma or intermyofibrillar spaces. Evidence: PCS. (PMID:25748484)
- Micrognathia (HP:0000347): Developmental hypoplasia of the mandible. Evidence: PCS. Frequency: 1/2. (PMID:25748484)
- Low-set ears (HP:0000369): Upper insertion of the ear to the scalp below an imaginary horizontal line drawn between the inner canthi of the eye and extending posteriorly to the ear. Evidence: PCS. Frequency: 1/2. Onset: Congenital onset (HP:0003577). (PMID:25748484)
- Cervical C2/C3 vertebral fusion (HP:0004602): Fusion of cervical vertebrae at C2 and C3, caused by a failure in the normal segmentation or division of the cervical vertebrae during the early weeks of fetal development, leading to a short neck with a low hairline at the back of the head, and restricted mobility of the upper spine. Evidence: PCS. Frequency: 2/2. Onset: Congenital onset (HP:0003577). (PMID:25748484)
These phenotypes are associated with the disease Klippel-Feil anomaly-myopathy-facial dysmorphism syndrome (OMIM:616549).